Phenotypes associated with the disease intellectual disability, autosomal recessive 58 (OMIM:617270):
- Axial hypotonia (HP:0008936): Muscular hypotonia (abnormally low muscle tone) affecting the musculature of the trunk. Evidence: PCS. Frequency: 2/2. (PMID:25847581)
- Poor head control (HP:0002421): Difficulty to maintain correct position of the head while standing or sitting. Infant head lag is observed when the head seems to flop around or lags posteriorly behind the trunk. Several articles have maintained that head lag should be absent by age 3 to 4 months. Evidence: PCS. Frequency: 2/2. (PMID:25847581)
- Spastic diplegia (HP:0001264): Spasticity (neuromuscular hypertonia) primarily in the muscles of the legs, hips, and pelvis. Evidence: PCS. Frequency: 2/2. (PMID:25847581)
- Congenital onset (HP:0003577): A phenotypic abnormality that is present at birth. Evidence: PCS. (PMID:25847581)
- Progressive (HP:0003676): Applies to a disease manifestation that increases in scope or severity over the course of time, i.e., that worsens with age. Evidence: PCS. (PMID:25847581)
- Delayed speech and language development (HP:0000750): A degree of language development that is significantly below the norm for a child of a specified age. Evidence: PCS. Frequency: 2/2. (PMID:25847581)
- Absent speech (HP:0001344): Complete lack of development of speech and language abilities. Evidence: PCS. Frequency: 2/2. (PMID:25847581)
- Short stature (HP:0004322): A height below that which is expected according to age and gender norms. Although there is no universally accepted definition of short stature, many refer to "short stature" as height more than 2 standard deviations below the mean for age and gender (or below the 3rd percentile for age and gender dependent norms). Evidence: PCS. Frequency: 1/2. (PMID:25847581)
- Choreoathetosis (HP:0001266): Involuntary movements characterized by both athetosis (inability to sustain muscles in a fixed position) and chorea (widespread jerky arrhythmic movements). Evidence: PCS. Frequency: 2/2. (PMID:25847581)
- Global developmental delay (HP:0001263): A delay in the achievement of motor or mental milestones in the domains of development of a child, including motor skills, speech and language, cognitive skills, and social and emotional skills. This term should only be used to describe children younger than five years of age. Evidence: PCS. Frequency: 2/2. (PMID:25847581)
- Infantile onset (HP:0003593): Onset of signs or symptoms of disease between 28 days to one year of life. Evidence: PCS. Frequency: 2/2. (PMID:25847581)
- Pica (HP:0011856): An appetite for and the persistent ingestion of non-food substances such as clay. In order to diagnose pica, this behavior must have persisted over a period of at least one month. Evidence: PCS. Frequency: 2/2. (PMID:25847581)
- Aggressive behavior (HP:0000718): Behavior or an act aimed at harming a person, animal, or physical property (e.g., acts of physical violence; shouting, swearing, and using harsh language; slashing someone's tires). Evidence: PCS. Frequency: 2/2. (PMID:25847581)
- Autosomal recessive inheritance (HP:0000007): A mode of inheritance that is observed for traits related to a gene encoded on one of the autosomes (i.e., the human chromosomes 1-22) in which a trait manifests in individuals with two pathogenic alleles, either homozygotes (two copies of the same mutant allele) or compound heterozygotes (whereby each copy of a gene has a distinct mutant allele). Evidence: PCS. (PMID:25847581)
- Motor stereotypy (HP:0000733): Use of the same abnormal action in response to certain triggers or at random. They may be used as a way to regulate one's internal state but must otherwise have no apparent functional purpose. Evidence: PCS. Frequency: 2/2. (PMID:25847581)
- Self-injurious behavior (HP:0100716): Self-aggression. Evidence: PCS. Frequency: 2/2. (PMID:25847581)
- Intellectual disability (HP:0001249): The term intellectual disability or intellectual developmental disorder is used to describe significantly sub-average intellectual and adaptive functioning based on clinical assessment and as measured by individually administered, appropriately normed, standardized and validated tests of intellectual functioning and adaptive behavior, with onset during the developmental period from infancy through adolescence. Evidence: PCS. Frequency: 2/2. (PMID:25847581)
- Hyperreflexia (HP:0001347): Hyperreflexia is the presence of hyperactive stretch reflexes of the muscles. Evidence: PCS. Frequency: 2/2. (PMID:25847581)